Phenotypes associated with the disease Familial articular hypermobility syndrome (ORPHA:2295):
- Joint hypermobility (HP:0001382): The capability that a joint (or a group of joints) has to move, passively and/or actively, beyond normal limits along physiological axes. Evidence: TAS. Frequency: Very frequent (HP:0040281). (ORPHA:2295)
- Congenital hip dislocation (HP:0001374). Evidence: TAS. Frequency: Very frequent (HP:0040281). (ORPHA:2295)
- Patellar dislocation (HP:0002999): The kneecap normally is located within the groove termed trochlea on the distal femur and can slide up and down in it. Patellar dislocation occurs if the patella fully dislocates out of the groove. Evidence: TAS. Frequency: Very frequent (HP:0040281). (ORPHA:2295)
- Abnormality of the knee (HP:0002815): An abnormality of the knee joint or surrounding structures. Evidence: TAS. Frequency: Frequent (HP:0040282). (ORPHA:2295)
- Inguinal hernia (HP:0000023): Protrusion of the contents of the abdominal cavity through the inguinal canal. Evidence: TAS. Frequency: Occasional (HP:0040283). (ORPHA:2295)
- Abnormal femur morphology (HP:0002823): Any anomaly of the structure of the femur. Evidence: TAS. Frequency: Occasional (HP:0040283). (ORPHA:2295)
- Shoulder dislocation (HP:0003834): A displacement or misalignment of the humerus with respect to the other bones of the should joint. Note that a subluxation is a partial dislocation. Evidence: TAS. Frequency: Occasional (HP:0040283). (ORPHA:2295)
- Abnormality of the elbow (HP:0009811): An anomaly of the joint that connects the upper and the lower arm. Evidence: TAS. Frequency: Occasional (HP:0040283). (ORPHA:2295)